- Iris cyst (HP:0011523): An iris cyst is composed of a single cell layer of epithelium and is filled with fluid. Evidence: PCS. (PMID:8874445)
- Autosomal dominant inheritance (HP:0000006): A mode of inheritance that is observed for traits related to a gene encoded on one of the autosomes (i.e., the human chromosomes 1-22) in which a trait manifests in heterozygotes. In the context of medical genetics, an autosomal dominant disorder is caused when a single copy of the mutant allele is present. Males and females are affected equally, and can both transmit the disorder with a risk of 50% for each child of inheriting the mutant allele. Evidence: PCS. (PMID:8874445)
These phenotypes are associated with the disease iris pigment epithelium anomalies (OMIM:601616).